- X-linked inheritance (HP:0001417): A mode of inheritance that is observed for traits related to a gene encoded on the X chromosome. Evidence: IEA. (OMIM:312200)
- Index finger dermatoglyphic radial loop (HP:0007566). Evidence: IEA. (OMIM:312200)
These phenotypes are associated with the disease RADIAL LOOP, PLAIN, ON RIGHT INDEX FINGER (OMIM:312200).